- Hypertrophic cardiomyopathy (HP:0001639): Hypertrophic cardiomyopathy (HCM) is defined by the presence of increased ventricular wall thickness or mass in the absence of loading conditions (hypertension, valve disease) sufficient to cause the observed abnormality. Evidence: PCS. Frequency: 1/1. (PMID:10462489)
- Adult onset (HP:0003581): Onset of disease manifestations in adulthood, defined here as at the age of 16 years or later. Evidence: PCS. Frequency: 1/1. (PMID:10462489)
- Autosomal dominant inheritance (HP:0000006): A mode of inheritance that is observed for traits related to a gene encoded on one of the autosomes (i.e., the human chromosomes 1-22) in which a trait manifests in heterozygotes. In the context of medical genetics, an autosomal dominant disorder is caused when a single copy of the mutant allele is present. Males and females are affected equally, and can both transmit the disorder with a risk of 50% for each child of inheriting the mutant allele. Evidence: PCS. (PMID:10462489)
These phenotypes are associated with the disease hypertrophic cardiomyopathy 9 (OMIM:613765).